- Cardiac myxoma (HP:0011672): A myxoma (tumor of primitive connective tissue) of the heart. Cardiac myxomas consist of stellate to plump, cytologically bland mesenchymal cells set in a myxoid stroma. Cardiac myxomas are of endocardial origin and general project from the endocardium into a cardiac chamber. Evidence: TAS. Frequency: Obligate (HP:0040280). (ORPHA:615)
- Pulmonic valve myxoma (HP:0006691): A benign tumor of connective tissue containing mucous or gelatinous material (myxoma) localized in the pumonic valve. Evidence: TAS. Frequency: Very frequent (HP:0040281). (ORPHA:615)
- Heart murmur (HP:0030148): An extra or unusual sound heard during a heartbeat caused vibrations resulting from the flow of blood through the heart. Evidence: TAS. Frequency: Very frequent (HP:0040281). (ORPHA:615)
- Exertional dyspnea (HP:0002875): Perceived difficulty to breathe that occurs with exercise or exertion and improves with rest. Evidence: TAS. Frequency: Frequent (HP:0040282). (ORPHA:615)
- Easy fatigability (HP:0003388): Increased susceptibility to fatigue. Evidence: TAS. Frequency: Frequent (HP:0040282). (ORPHA:615)
- Jaundice (HP:0000952): Yellow pigmentation of the skin due to bilirubin, which in turn is the result of increased bilirubin concentration in the bloodstream. Evidence: TAS. Frequency: Occasional (HP:0040283). (ORPHA:615)
- Cholestasis (HP:0001396): Impairment of bile flow due to obstruction in bile ducts. Evidence: TAS. Frequency: Occasional (HP:0040283). (ORPHA:615)
- Ascites (HP:0001541): Accumulation of fluid in the peritoneal cavity (between the layers of the peritoneum that lines the abdomen). Evidence: TAS. Frequency: Occasional (HP:0040283). (ORPHA:615)
- Congestive heart failure (HP:0001635): The presence of an abnormality of cardiac function that is responsible for the failure of the heart to pump blood at a rate that is commensurate with the needs of the tissues or a state in which abnormally elevated filling pressures are required for the heart to do so. Heart failure is frequently related to a defect in myocardial contraction. Evidence: TAS. Frequency: Occasional (HP:0040283). (ORPHA:615)
- Cardiomegaly (HP:0001640): Increased size of the heart, clinically defined as an increased transverse diameter of the cardiac silhouette that is greater than or equal to 50% of the transverse diameter of the chest (increased cardiothoracic ratio) on a posterior-anterior projection of a chest radiograph or a computed tomography. Evidence: TAS. Frequency: Occasional (HP:0040283). (ORPHA:615)
- Thromboembolism (HP:0001907): The formation of a blood clot inside a blood vessel that subsequently travels through the blood stream from the site where it formed to another location in the body, generally leading to vascular occlusion at the distant site. Evidence: TAS. Frequency: Occasional (HP:0040283). (ORPHA:615)
- Fever (HP:0001945): Body temperature elevated above the normal range. Evidence: TAS. Frequency: Occasional (HP:0040283). (ORPHA:615)
- Tricuspid regurgitation (HP:0005180): Failure of the tricuspid valve to close sufficiently upon contraction of the right ventricle, causing blood to regurgitate (flow backward) into the right atrium. Evidence: TAS. Frequency: Occasional (HP:0040283). (ORPHA:615)
- Bacterial endocarditis (HP:0006689): A bacterial infection of the endocardium, the inner layer of the heart, which usually involves the heart valves. Evidence: TAS. Frequency: Occasional (HP:0040283). (ORPHA:615)
- Pedal edema (HP:0010741): An abnormal accumulation of excess fluid in the lower extremity resulting in swelling of the feet and extending upward to the lower leg. Evidence: TAS. Frequency: Occasional (HP:0040283). (ORPHA:615)
- Chest pain (HP:0100749): An unpleasant sensation characterized by physical discomfort (such as pricking, throbbing, or aching) localized to the chest. Evidence: TAS. Frequency: Occasional (HP:0040283). (ORPHA:615)
- Vascular dilatation (HP:0002617): An abnormal increase in the diameter of an artery or vein, either as a diffuse dilatation or as a localized, sac-like outpouching of the vessel wall (aneurysm). Evidence: TAS. Frequency: Very rare (HP:0040284). (ORPHA:615)
- Dilatation of the cerebral artery (HP:0004944): The presence of a localized dilatation or ballooning of a cerebral artery. Evidence: TAS. Frequency: Very rare (HP:0040284). (ORPHA:615)
These phenotypes are associated with the disease Familial atrial myxoma (ORPHA:615).